Phenotypes associated with the disease ptosis-strabismus-ectopic pupils syndrome (OMIM:178330):
- Strabismus (HP:0000486): A misalignment of the eyes so that the visual axes deviate from bifoveal fixation. The classification of strabismus may be based on a number of features including the relative position of the eyes, whether the deviation is latent or manifest, intermittent or constant, concomitant or otherwise and according to the age of onset and the relevance of any associated refractive error. Evidence: IEA. (OMIM:178330)
- Ptosis (HP:0000508): The upper eyelid margin is positioned 3 mm or more lower than usual and covers the superior portion of the iris (objective); or, the upper lid margin obscures at least part of the pupil (subjective). Evidence: IEA. (OMIM:178330)
- Autosomal dominant inheritance (HP:0000006): A mode of inheritance that is observed for traits related to a gene encoded on one of the autosomes (i.e., the human chromosomes 1-22) in which a trait manifests in heterozygotes. In the context of medical genetics, an autosomal dominant disorder is caused when a single copy of the mutant allele is present. Males and females are affected equally, and can both transmit the disorder with a risk of 50% for each child of inheriting the mutant allele. Evidence: IEA. (OMIM:178330)